Phenotypes associated with the disease autosomal recessive nonsyndromic hearing loss 102 (OMIM:615974):
- Congenital onset (HP:0003577): A phenotypic abnormality that is present at birth. Evidence: TAS. (OMIM:615974)
- Autosomal recessive inheritance (HP:0000007): A mode of inheritance that is observed for traits related to a gene encoded on one of the autosomes (i.e., the human chromosomes 1-22) in which a trait manifests in individuals with two pathogenic alleles, either homozygotes (two copies of the same mutant allele) or compound heterozygotes (whereby each copy of a gene has a distinct mutant allele). Evidence: PCS. (PMID:24741995)
- Profound hearing impairment (HP:0012715): A profound (essentially complete) form of hearing impairment. Evidence: PCS. (PMID:24741995)